- Opisthotonus (HP:0002179): Opisthotonus is defined as a dramatic abnormal posture due to spastic contraction of the extensor muscles of the neck, trunk, and lower extremities that produces a severe backward arching from neck to heel. In most cases, the trunk is elevated off the ground by a few inches. It is usually sudden in onset and can be sustained or repetitive. It can be considered a variant of decerebrate posturing involving a hyperextension of the neck, back, and limbs. Evidence: PCS. Frequency: 1/2. (PMID:20080937)
- Type I transferrin isoform profile (HP:0003642): Abnormal transferrin isoform profile consistent with a type I congenital disorder of glycosylation. In the traditional nomenclature for congenital disorders of glycosylation, absence of entire glycans was designated type I, and loss of one or more monosaccharides as type II. Evidence: PCS. Frequency: 1/1. (PMID:20080937)
- Microcephaly (HP:0000252): Head circumference below 2 standard deviations below the mean for age and gender. Evidence: PCS. Frequency: 1/2. (PMID:20080937)
- Absent speech (HP:0001344): Complete lack of development of speech and language abilities. Evidence: TAS. (OMIM:613661)
- Strabismus (HP:0000486): A misalignment of the eyes so that the visual axes deviate from bifoveal fixation. The classification of strabismus may be based on a number of features including the relative position of the eyes, whether the deviation is latent or manifest, intermittent or constant, concomitant or otherwise and according to the age of onset and the relevance of any associated refractive error. Evidence: TAS. (OMIM:613661)
- Vomiting (HP:0002013): Forceful ejection of the contents of the stomach through the mouth by means of a series of involuntary spasmic contractions. Evidence: PCS. Frequency: 2/2. (PMID:20080937)
- Feeding difficulties (HP:0011968): Impaired ability to eat related to problems gathering food and getting ready to suck, chew, or swallow it. Evidence: PCS. Frequency: 1/2. (PMID:20080937)
- Seizure (HP:0001250): A seizure is an intermittent abnormality of nervous system physiology characterized by a transient occurrence of signs and/or symptoms due to abnormal excessive or synchronous neuronal activity in the brain. Evidence: PCS. Frequency: 2/2. (PMID:20080937)
- Global developmental delay (HP:0001263): A delay in the achievement of motor or mental milestones in the domains of development of a child, including motor skills, speech and language, cognitive skills, and social and emotional skills. This term should only be used to describe children younger than five years of age. Evidence: TAS. Frequency: 20/20. (OMIM:613661)
- Hypotonia (HP:0001252): Hypotonia is an abnormally low muscle tone (the amount of tension or resistance to movement in a muscle). Even when relaxed, muscles have a continuous and passive partial contraction which provides some resistance to passive stretching. Hypotonia thus manifests as diminished resistance to passive stretching. Hypotonia is not the same as muscle weakness, although the two conditions can co-exist. Evidence: PCS. Frequency: 2/2. (PMID:20080937)
- Infantile onset (HP:0003593): Onset of signs or symptoms of disease between 28 days to one year of life. Evidence: PCS. Frequency: 1/2. (PMID:20080937)
- Inverted nipples (HP:0003186): The presence of nipples that instead of pointing outward are retracted inwards. Evidence: PCS. Frequency: 1/2. (PMID:20080937)
- Low anterior hairline (HP:0000294): Distance between the hairline (trichion) and the glabella (the most prominent point on the frontal bone above the root of the nose), in the midline, more than two SD below the mean. Alternatively, an apparently decreased distance between the hairline and the glabella. Evidence: PCS. Frequency: 1/2. (PMID:20080937)
- Death in childhood (HP:0003819): Death in during childhood, defined here as between the ages of 2 and 10 years. Evidence: PCS. Frequency: 1/2. (PMID:20080937)
- Sensorineural hearing impairment (HP:0000407): A type of hearing impairment in one or both ears related to an abnormal functionality of the cochlear nerve. Evidence: PCS. Frequency: 2/2. (PMID:20080937)
- EEG with generalized epileptiform discharges (HP:0011198): EEG discharges recorded on the entire scalp typically seen in persons with epilepsy. Evidence: PCS. Frequency: 2/2. (PMID:20080937)
- Autosomal recessive inheritance (HP:0000007): A mode of inheritance that is observed for traits related to a gene encoded on one of the autosomes (i.e., the human chromosomes 1-22) in which a trait manifests in individuals with two pathogenic alleles, either homozygotes (two copies of the same mutant allele) or compound heterozygotes (whereby each copy of a gene has a distinct mutant allele). Evidence: PCS. (PMID:20080937)
- High forehead (HP:0000348): An abnormally increased height of the forehead. Evidence: PCS. Frequency: 1/2. (PMID:20080937)
- Hyperammonemia (HP:0001987): An increased concentration of ammonia in the blood. Evidence: PCS. Frequency: 1/2. (PMID:20080937)
- Neonatal hypotonia (HP:0001319): Muscular hypotonia (abnormally low muscle tone) manifesting in the neonatal period. Evidence: TAS. (OMIM:613661)
- Temperature instability (HP:0005968): Disordered thermoregulation characterized by an impaired ability to maintain a balance between heat production and heat loss, with resulting instability of body temperature. Evidence: TAS. (OMIM:613661)
- Neonatal onset (HP:0003623): Onset of signs or symptoms of disease within the first 28 days of life. Evidence: PCS. Frequency: 1/2. (PMID:20080937)
These phenotypes are associated with the disease ALG11-congenital disorder of glycosylation (OMIM:613661).